- Aminoglycoside-induced hearing loss (HP:0011975): Partial or complete loss of hearing following ingestion of aminoglycoside antibiotics. Evidence: PCS. (PMID:16152638)
- Mitochondrial inheritance (HP:0001427): A mode of inheritance that is observed for traits related to a gene encoded on the mitochondrial genome. Because the mitochondrial genome is essentially always maternally inherited, a mitochondrial condition can only be transmitted by females, although the condition can affect both sexes. The proportion of mutant mitochondria can vary (heteroplasmy). Evidence: PCS. (PMID:16152638)
These phenotypes are associated with the disease deafness, aminoglycoside-induced (OMIM:580000).